Phenotypes associated with the disease Hypertelorism-microtia-facial clefting syndrome (ORPHA:2213):
- Median cleft palate (HP:0009099): Cleft palate of the midline of the palate. Evidence: TAS. Frequency: Very frequent (HP:0040281). (ORPHA:2213)
- Microcephaly (HP:0000252): Head circumference below 2 standard deviations below the mean for age and gender. Evidence: TAS. Frequency: Very frequent (HP:0040281). (ORPHA:2213)
- Hypertelorism (HP:0000316): Interpupillary distance more than 2 SD above the mean (alternatively, the appearance of an increased interpupillary distance or widely spaced eyes). Evidence: TAS. Frequency: Very frequent (HP:0040281). (ORPHA:2213)
- Atresia of the external auditory canal (HP:0000413): Absence or failure to form of the external auditory canal. Evidence: TAS. Frequency: Very frequent (HP:0040281). (ORPHA:2213)
- Microtia (HP:0008551): Underdevelopment of the external ear. Evidence: TAS. Frequency: Very frequent (HP:0040281). (ORPHA:2213)
- Horseshoe kidney (HP:0000085): A connection of the right and left kidney by an isthmus of functioning renal parenchyma or fibrous tissue that crosses the midline. Evidence: TAS. Frequency: Frequent (HP:0040282). (ORPHA:2213)
- Conductive hearing impairment (HP:0000405): An abnormality of vibrational conductance of sound to the inner ear leading to impairment of sensory perception of sound. Evidence: TAS. Frequency: Frequent (HP:0040282). (ORPHA:2213)
- Intellectual disability (HP:0001249): The term intellectual disability or intellectual developmental disorder is used to describe significantly sub-average intellectual and adaptive functioning based on clinical assessment and as measured by individually administered, appropriately normed, standardized and validated tests of intellectual functioning and adaptive behavior, with onset during the developmental period from infancy through adolescence. Evidence: TAS. Frequency: Frequent (HP:0040282). (ORPHA:2213)
- Global developmental delay (HP:0001263): A delay in the achievement of motor or mental milestones in the domains of development of a child, including motor skills, speech and language, cognitive skills, and social and emotional skills. This term should only be used to describe children younger than five years of age. Evidence: TAS. Frequency: Frequent (HP:0040282). (ORPHA:2213)
- Specific learning disability (HP:0001328): Impairment of certain skills such as reading or writing, coordination, self-control, or attention that interfere with the ability to learn. The impairment is not related to a global deficiency of intelligence. Evidence: TAS. Frequency: Frequent (HP:0040282). (ORPHA:2213)
- Thenar muscle atrophy (HP:0003393): Wasting of thenar muscles, which are located on palm of the hand at the base of the thumb. Evidence: TAS. Frequency: Frequent (HP:0040282). (ORPHA:2213)
- Severe short stature (HP:0003510): A severe degree of short stature, more than -4 SD from the mean corrected for age and sex. Evidence: TAS. Frequency: Frequent (HP:0040282). (ORPHA:2213)
- Crossed fused renal ectopia (HP:0004736): A developmental anomaly in which the kidneys are fused and localized on the same side of the midline. This anomaly is thought to result from disruption of the normal embryologic migration of the kidneys. Evidence: TAS. Frequency: Frequent (HP:0040282). (ORPHA:2213)
- Bifid nasal tip (HP:0000456): A splitting of the nasal tip. Visually assessable vertical indentation, cleft, or depression of the nasal tip. Evidence: TAS. Frequency: Occasional (HP:0040283). (ORPHA:2213)
- Bifid nose (HP:0011803): Visually assessable vertical indentation, cleft, or depression of the nasal bridge, ridge and tip. Evidence: TAS. Frequency: Occasional (HP:0040283). (ORPHA:2213)